- X-linked inheritance (HP:0001417): A mode of inheritance that is observed for traits related to a gene encoded on the X chromosome. Evidence: IEA. (OMIM:314380)
- Abnormality of the eye (HP:0000478): Any abnormality of the eye, including location, spacing, and intraocular abnormalities. Evidence: IEA. (OMIM:314380)
These phenotypes are associated with the disease unique green phenomenon (OMIM:314380).